- Typified by somatic mosaicism (HP:0001442): Description of conditions in which affected individuals typically display somatic mosaicism, i.e., genetically distinct populations of somatic cells in a given organism caused by DNA mutations, epigenetic alterations of DNA, chromosomal abnormalities or the spontaneous reversion of inherited mutations. In many conditions typified by somatic mosaicism, constitutive mutation is lethal and cases are exclusively or predominantly mosaic. Evidence: IEA. (OMIM:176807)
- Prostate cancer (HP:0012125): A cancer of the prostate. Evidence: TAS. (OMIM:176807)
- Autosomal dominant inheritance (HP:0000006): A mode of inheritance that is observed for traits related to a gene encoded on one of the autosomes (i.e., the human chromosomes 1-22) in which a trait manifests in heterozygotes. In the context of medical genetics, an autosomal dominant disorder is caused when a single copy of the mutant allele is present. Males and females are affected equally, and can both transmit the disorder with a risk of 50% for each child of inheriting the mutant allele. Evidence: TAS. (OMIM:176807)
These phenotypes are associated with the disease prostate cancer, hereditary (OMIM:176807).